- Failure to thrive (HP:0001508): Failure to thrive (FTT) refers to a child whose physical growth is substantially below the norm. Evidence: TAS. Frequency: Frequent (HP:0040282). (ORPHA:91359)
- Diffuse reticular or finely nodular infiltrations (HP:0002207). Evidence: TAS. Frequency: Frequent (HP:0040282). (ORPHA:91359)
- Hyperventilation (HP:0002883): Hyperventilation refers to an increased pulmonary ventilation rate that is faster than necessary for the exchange of gases. Hyperventilation can result from increased frequency of breathing, an increased tidal volume, or both, and leads to an excess intake of oxygen and the blowing off of carbon dioxide. Evidence: TAS. Frequency: Frequent (HP:0040282). (ORPHA:91359)
- Hypoxemia (HP:0012418): An abnormally low level of blood oxygen. Evidence: TAS. Frequency: Frequent (HP:0040282). (ORPHA:91359)
- Cough (HP:0012735): A sudden, audible expulsion of air from the lungs through a partially closed glottis, preceded by inhalation. Evidence: TAS. Frequency: Frequent (HP:0040282). (ORPHA:91359)
- Ground-glass opacification (HP:0025179): On chest radiographs, ground-glass opacity appears as an area of hazy increased lung opacity, usually extensive, within which margins of pulmonary vessels may be indistinct. On CT scans, it appears as hazy increased opacity of lung, with preservation of bronchial and vascular margins. It is caused by partial filling of airspaces, interstitial thickening (due to fluid, cells, and/or fibrosis), partial collapse of alveoli, increased capillary blood volume, or a combination of these, the common factor being the partial displacement of air. Ground-glass opacity is less opaque than consolidation, in which bronchovascular margins are obscured. Evidence: TAS. Frequency: Frequent (HP:0040282). (ORPHA:91359)
- Reduced forced vital capacity (HP:0032341): An abnormal reduction in the amount of air a person can expel following maximal inspiration. Evidence: TAS. Frequency: Frequent (HP:0040282). (ORPHA:91359)
- Cyanosis (HP:0000961): Bluish discoloration of the skin and mucosa due to poor circulation or inadequate oxygenation of arterial or capillary blood. Evidence: TAS. Frequency: Occasional (HP:0040283). (ORPHA:91359)
- Fever (HP:0001945): Body temperature elevated above the normal range. Evidence: TAS. Frequency: Occasional (HP:0040283). (ORPHA:91359)
- Respiratory distress (HP:0002098): Respiratory distress is objectively observable as the physical or emotional consequences from the experience of dyspnea. The physical presentation of respiratory distress is generally referred to as labored breathing, while the sensation of respiratory distress is called shortness of breath or dyspnea. Evidence: TAS. Frequency: Occasional (HP:0040283). (ORPHA:91359)
- Tachypnea (HP:0002789): Very rapid breathing. Evidence: TAS. Frequency: Occasional (HP:0040283). (ORPHA:91359)
- Intercostal retractions (HP:0030864): A pulling inward of the soft tissues between the ribs upon inhalation. This is a sign of increased use of the chest muscles for breathing and is a manifestation of respiratory distress. Evidence: TAS. Frequency: Occasional (HP:0040283). (ORPHA:91359)
- Mediastinal lymphadenopathy (HP:0100721): Swelling of lymph nodes within the mediastinum, the central compartment of the thoracic cavities that contains the heart and the great vessels, the esophagus, and trachea and other structures including lymph nodes. Evidence: TAS. Frequency: Very rare (HP:0040284). (ORPHA:91359)
These phenotypes are associated with the disease Chronic pneumonitis of infancy (ORPHA:91359).